Phenotypes associated with the disease ventricular fibrillation, paroxysmal familial, 2 (OMIM:612956):
- Ventricular fibrillation (HP:0001663): Uncontrolled contractions of muscles fibers in the left ventricle not producing contraction of the left ventricle. Ventricular fibrillation usually begins with a ventricular premature contraction and a short run of rapid ventricular tachycardia degenerating into uncoordinating ventricular fibrillations. Evidence: PCS. (PMID:19285295)
- Premature ventricular contraction (HP:0006682): Premature ventricular contractions (PVC) or ventricular extrasystoles are premature contractions of the heart that arise in response to an impulse in the ventricles rather than the normal impulse from the sinoatrial (SA) node. Evidence: PCS. (PMID:19285295)
- Sudden cardiac death (HP:0001645): The heart suddenly and unexpectedly stops beating resulting in death within a short time period (generally within 1 h of symptom onset). Evidence: PCS. Frequency: Occasional (HP:0040283). Onset: Adult onset (HP:0003581). (PMID:19285295)
- Autosomal dominant inheritance (HP:0000006): A mode of inheritance that is observed for traits related to a gene encoded on one of the autosomes (i.e., the human chromosomes 1-22) in which a trait manifests in heterozygotes. In the context of medical genetics, an autosomal dominant disorder is caused when a single copy of the mutant allele is present. Males and females are affected equally, and can both transmit the disorder with a risk of 50% for each child of inheriting the mutant allele. Evidence: PCS. (PMID:19285295)